Phenotypes associated with the disease Spinocerebellar ataxia type 41 (ORPHA:458798):
- Gait ataxia (HP:0002066): A type of ataxia characterized by the impairment of the ability to coordinate the movements required for normal walking. Gait ataxia is characteirzed by a wide-based staggering gait with a tendency to fall. Evidence: TAS. Frequency: Frequent (HP:0040282). (ORPHA:458798)
- Postural instability (HP:0002172): A tendency to fall or the inability to keep oneself from falling; imbalance. The retropulsion test is widely regarded as the gold standard to evaluate postural instability, Use of the retropulsion test includes a rapid balance perturbation in the backward direction, and the number of balance correcting steps (or total absence thereof) is used to rate the degree of postural instability. Healthy subjects correct such perturbations with either one or two large steps, or without taking any steps, hinging rapidly at the hips while swinging the arms forward as a counterweight. In patients with balance impairment, balance correcting steps are often too small, forcing patients to take more than two steps. Taking three or more steps is generally considered to be abnormal, and taking more than five steps is regarded as being clearly abnormal. Markedly affected patients continue to step backward without ever regaining their balance and must be caught by the examiner (this would be called true retropulsion). Even more severely affected patients fail to correct entirely, and fall backward like a pushed toy soldier, without taking any corrective steps. Evidence: TAS. Frequency: Frequent (HP:0040282). (ORPHA:458798)
- Cerebellar vermis atrophy (HP:0006855): Wasting (atrophy) of the vermis of cerebellum. Evidence: TAS. Frequency: Frequent (HP:0040282). (ORPHA:458798)